- Generalized hirsutism (HP:0002230): Abnormally increased hair growth over much of the entire body. Evidence: TAS. Frequency: Frequent (HP:0040282). (ORPHA:1671)
- Scoliosis (HP:0002650): The presence of an abnormal lateral curvature of the spine. Evidence: TAS. Frequency: Frequent (HP:0040282). (ORPHA:1671)
- Diastomatomyelia (HP:0100563): Coexistence of two hemicords, at variable levels, causing splaying of the posterior vertebral elements. Results in neurological deficits in lower limb or perineum. Evidence: TAS. Frequency: Very frequent (HP:0040281). (ORPHA:1671)
These phenotypes are associated with the disease Split cord malformation type I (ORPHA:1671).